Phenotypes associated with the disease autosomal recessive nonsyndromic hearing loss 1A (OMIM:220290):
- Abnormal vestibular function (HP:0001751): An abnormality of the functioning of the vestibular apparatus. Evidence: TAS. Frequency: Occasional (HP:0040283). (OMIM:220290)
- Sensorineural hearing impairment (HP:0000407): A type of hearing impairment in one or both ears related to an abnormal functionality of the cochlear nerve. Evidence: TAS. (OMIM:220290)
- Digenic inheritance (HP:0010984): A type of multifactorial inheritance governed by the simultaneous action of two gene loci. Evidence: PCS. (PMID:19050930)
- Autosomal recessive inheritance (HP:0000007): A mode of inheritance that is observed for traits related to a gene encoded on one of the autosomes (i.e., the human chromosomes 1-22) in which a trait manifests in individuals with two pathogenic alleles, either homozygotes (two copies of the same mutant allele) or compound heterozygotes (whereby each copy of a gene has a distinct mutant allele). Evidence: PCS. (PMID:9139825)